- Chronic rhinitis (HP:0002257): Chronic inflammation of the nasal mucosa. Evidence: PCS. Frequency: 4/11. (PMID:22581229)
- Ciliary dyskinesia (HP:0012265): A deviation from the normally well coordinated pattern of intracellular and intercellular synchrony of motile cilia. Dyskinetic cilia usually beat out of synchrony relative to neighboring cilia. Evidence: PCS. (PMID:22581229)
- Congenital onset (HP:0003577): A phenotypic abnormality that is present at birth. Evidence: PCS. (PMID:22581229)
- Situs inversus totalis (HP:0001696): A left-right reversal (or mirror reflection) of the anatomical location of the major thoracic and abdominal organs. Evidence: PCS. Frequency: 4/11. (PMID:22581229)
- Dynein arm defect of respiratory motile cilia (HP:0012255): An anomaly of the dynein arms of motile cilia. This feature is usually appreciated by electron microscopy. Evidence: PCS. Frequency: 6/6. (PMID:22581229)
- Dextrocardia (HP:0001651): The heart is located in the right hand sided hemithorax. That is, there is a left-right reversal (or "mirror reflection") of the anatomical location of the heart in which the heart is locate on the right side instead of the left. Evidence: PCS. Frequency: 3/11. (PMID:22581229)
- Bronchiectasis (HP:0002110): Persistent abnormal dilatation of the bronchi owing to localized and irreversible destruction and widening of the large airways. Evidence: PCS. (PMID:22581229)
- Autosomal recessive inheritance (HP:0000007): A mode of inheritance that is observed for traits related to a gene encoded on one of the autosomes (i.e., the human chromosomes 1-22) in which a trait manifests in individuals with two pathogenic alleles, either homozygotes (two copies of the same mutant allele) or compound heterozygotes (whereby each copy of a gene has a distinct mutant allele). Evidence: PCS. (PMID:22581229)
- Cough (HP:0012735): A sudden, audible expulsion of air from the lungs through a partially closed glottis, preceded by inhalation. Evidence: PCS. (PMID:22581229)
- Recurrent otitis media (HP:0000403): Increased susceptibility to otitis media, as manifested by recurrent episodes of otitis media. Evidence: PCS. Frequency: 1/11. (PMID:22581229)
- Chronic sinusitis (HP:0011109): A chronic form of sinusitis. Evidence: PCS. (PMID:22581229)
- Recurrent respiratory infections (HP:0002205): An increased susceptibility to respiratory infections as manifested by a history of recurrent respiratory infections. Evidence: PCS. Frequency: 5/11. (PMID:22581229)
These phenotypes are associated with the disease primary ciliary dyskinesia 17 (OMIM:614679).